- Low-set ears (HP:0000369): Upper insertion of the ear to the scalp below an imaginary horizontal line drawn between the inner canthi of the eye and extending posteriorly to the ear. Evidence: TAS. Frequency: Very frequent (HP:0040281). (ORPHA:2008)
- Split hand (HP:0001171): A condition in which middle parts of the hand (fingers and metacarpals) are missing giving a cleft appearance. The severity is very variable ranging from slightly hypoplastic middle fingers over absent middle fingers as far as oligo- or monodactyl hands. Evidence: TAS. Frequency: Very frequent (HP:0040281). (ORPHA:2008)
- Intellectual disability (HP:0001249): The term intellectual disability or intellectual developmental disorder is used to describe significantly sub-average intellectual and adaptive functioning based on clinical assessment and as measured by individually administered, appropriately normed, standardized and validated tests of intellectual functioning and adaptive behavior, with onset during the developmental period from infancy through adolescence. Evidence: TAS. Frequency: Very frequent (HP:0040281). (ORPHA:2008)
- Feeding difficulties in infancy (HP:0008872): Impaired feeding performance of an infant as manifested by difficulties such as weak and ineffective sucking, brief bursts of sucking, and falling asleep during sucking. There may be difficulties with chewing or maintaining attention. Evidence: TAS. Frequency: Very frequent (HP:0040281). (ORPHA:2008)
- Cryptorchidism (HP:0000028): Testis in inguinal canal. That is, absence of one or both testes from the scrotum owing to failure of the testis or testes to descend through the inguinal canal to the scrotum. Evidence: TAS. Frequency: Frequent (HP:0040282). (ORPHA:2008)
- Hypospadias (HP:0000047): Abnormal position of urethral meatus on the ventral penile shaft (underside) characterized by displacement of the urethral meatus from the tip of the glans penis to the ventral surface of the penis, scrotum, or perineum. Evidence: TAS. Frequency: Frequent (HP:0040282). (ORPHA:2008)
- Cleft palate (HP:0000175): Cleft palate is a developmental defect of the palate resulting from a failure of fusion of the palatine processes and manifesting as a separation of the roof of the mouth (soft and hard palate). Evidence: TAS. Frequency: Frequent (HP:0040282). (ORPHA:2008)
- Cleft upper lip (HP:0000204): A gap or groove in the upper lip. This is a congenital defect resulting from nonfusion of tissues of the lip during embryonal development. Evidence: TAS. Frequency: Frequent (HP:0040282). (ORPHA:2008)
- Hypertelorism (HP:0000316): Interpupillary distance more than 2 SD above the mean (alternatively, the appearance of an increased interpupillary distance or widely spaced eyes). Evidence: TAS. Frequency: Frequent (HP:0040282). (ORPHA:2008)
- High forehead (HP:0000348): An abnormally increased height of the forehead. Evidence: TAS. Frequency: Frequent (HP:0040282). (ORPHA:2008)
- Wide nasal bridge (HP:0000431): Increased breadth of the nasal bridge (and with it, the nasal root). Evidence: TAS. Frequency: Frequent (HP:0040282). (ORPHA:2008)
- Long eyelashes (HP:0000527): Mid upper eyelash length >10 mm or increased length of the eyelashes (subjective). Evidence: TAS. Frequency: Frequent (HP:0040282). (ORPHA:2008)
- Intrauterine growth retardation (HP:0001511): An abnormal restriction of fetal growth with fetal weight below the tenth percentile for gestational age. Evidence: TAS. Frequency: Frequent (HP:0040282). (ORPHA:2008)
- Split foot (HP:0001839): A condition in which middle parts of the foot (toes and metatarsals) are missing giving a cleft appearance. The severity is very variable ranging from slightly hypoplastic 3rd toe over absent 2nd or 3rd toes as far as oligo- or monodactyl feet. Evidence: TAS. Frequency: Frequent (HP:0040282). (ORPHA:2008)
- Cerebral cortical atrophy (HP:0002120): Atrophy of the cortex of the cerebrum. Evidence: TAS. Frequency: Frequent (HP:0040282). (ORPHA:2008)
- Abnormal metacarpal morphology (HP:0005916): Any abnormal shape or structure of the metacarpal bones. Evidence: TAS. Frequency: Frequent (HP:0040282). (ORPHA:2008)
- Hypoplasia of penis (HP:0008736). Evidence: TAS. Frequency: Frequent (HP:0040282). (ORPHA:2008)
- Proptosis (HP:0000520): An eye that is protruding anterior to the plane of the face to a greater extent than is typical. Evidence: TAS. Frequency: Occasional (HP:0040283). (ORPHA:2008)
- Hyperthyroidism (HP:0000836): An abnormality of thyroid physiology characterized by excessive secretion of the thyroid hormones thyroxine (i.e., T4) and/or 3,3',5-triiodo-L-thyronine zwitterion (i.e., triiodothyronine or T3). Evidence: TAS. Frequency: Occasional (HP:0040283). (ORPHA:2008)
- Seizure (HP:0001250): A seizure is an intermittent abnormality of nervous system physiology characterized by a transient occurrence of signs and/or symptoms due to abnormal excessive or synchronous neuronal activity in the brain. Evidence: TAS. Frequency: Occasional (HP:0040283). (ORPHA:2008)
- Hypotonia (HP:0001252): Hypotonia is an abnormally low muscle tone (the amount of tension or resistance to movement in a muscle). Even when relaxed, muscles have a continuous and passive partial contraction which provides some resistance to passive stretching. Hypotonia thus manifests as diminished resistance to passive stretching. Hypotonia is not the same as muscle weakness, although the two conditions can co-exist. Evidence: TAS. Frequency: Occasional (HP:0040283). (ORPHA:2008)
- Hypertonia (HP:0001276): A condition in which there is increased muscle tone so that arms or legs, for example, are stiff and difficult to move. Evidence: TAS. Frequency: Occasional (HP:0040283). (ORPHA:2008)
- Joint dislocation (HP:0001373): Displacement or malalignment of joints. Evidence: TAS. Frequency: Occasional (HP:0040283). (ORPHA:2008)
- Death in infancy (HP:0001522): Death within the first 24 months of life. Evidence: TAS. Frequency: Occasional (HP:0040283). (ORPHA:2008)
- Ventricular septal defect (HP:0001629): A hole between the two bottom chambers (ventricles) of the heart. The defect is centered around the most superior aspect of the ventricular septum. Evidence: TAS. Frequency: Occasional (HP:0040283). (ORPHA:2008)
- Atrial septal defect (HP:0001631): Atrial septal defect (ASD) is a congenital abnormality of the interatrial septum that enables blood flow between the left and right atria via the interatrial septum. Evidence: TAS. Frequency: Occasional (HP:0040283). (ORPHA:2008)
- Tetralogy of Fallot (HP:0001636): A congenital cardiac malformation comprising pulmonary stenosis, overriding aorta, ventricular septum defect, and right ventricular hypertrophy. The diagnosis of TOF is made if at least three of the four above mentioned features are present. Evidence: TAS. Frequency: Occasional (HP:0040283). (ORPHA:2008)
- Truncus arteriosus (HP:0001660): A single arterial trunk arises from the cardiac mass. The pulmonary arteries, aorta and coronary arteries arise from this single trunk with no evidence of another outflow tract. Evidence: TAS. Frequency: Occasional (HP:0040283). (ORPHA:2008)
- Coarctation of aorta (HP:0001680): Coarctation of the aorta is a narrowing or constriction of a segment of the aorta. Evidence: TAS. Frequency: Occasional (HP:0040283). (ORPHA:2008)
- Mitral stenosis (HP:0001718): An abnormal narrowing of the orifice of the mitral valve. Evidence: TAS. Frequency: Occasional (HP:0040283). (ORPHA:2008)
- Toe syndactyly (HP:0001770): Webbing or fusion of the toes, involving soft parts only or including bone structure. Bony fusions are referred to as "bony" Syndactyly if the fusion occurs in a radio-ulnar axis. Fusions of bones of the toes in a proximo-distal axis are referred to as "Symphalangism". Evidence: TAS. Frequency: Occasional (HP:0040283). (ORPHA:2008)
- Hallux valgus (HP:0001822): Lateral deviation of the great toe (i.e., in the direction of the little toe). Evidence: TAS. Frequency: Occasional (HP:0040283). (ORPHA:2008)
- Foot polydactyly (HP:0001829): A kind of polydactyly characterized by the presence of a supernumerary toe or toes. Evidence: TAS. Frequency: Occasional (HP:0040283). (ORPHA:2008)
- Anal atresia (HP:0002023): Congenital absence of the anus, i.e., the opening at the bottom end of the intestinal tract. Evidence: TAS. Frequency: Occasional (HP:0040283). (ORPHA:2008)
- Finger syndactyly (HP:0006101): Webbing or fusion of the fingers, involving soft parts only or including bone structure. Bony fusions are referred to as "bony" Syndactyly if the fusion occurs in a radio-ulnar axis. Fusions of bones of the fingers in a proximo-distal axis are referred to as "Symphalangism". Evidence: TAS. Frequency: Occasional (HP:0040283). (ORPHA:2008)
- Camptodactyly of finger (HP:0100490): The distal interphalangeal joint and/or the proximal interphalangeal joint of the fingers cannot be extended to 180 degrees by either active or passive extension. Evidence: TAS. Frequency: Occasional (HP:0040283). (ORPHA:2008)
- Urogenital fistula (HP:0100589): The presence of a fistula affecting the genitourinary system. Evidence: TAS. Frequency: Occasional (HP:0040283). (ORPHA:2008)
These phenotypes are associated with the disease Acrocardiofacial syndrome (ORPHA:2008).